Phenotypes associated with the disease Lamb-Shaffer syndrome (ORPHA:530983):
- Intellectual disability (HP:0001249): The term intellectual disability or intellectual developmental disorder is used to describe significantly sub-average intellectual and adaptive functioning based on clinical assessment and as measured by individually administered, appropriately normed, standardized and validated tests of intellectual functioning and adaptive behavior, with onset during the developmental period from infancy through adolescence. Evidence: TAS. Frequency: Very frequent (HP:0040281). (ORPHA:530983)
- Global developmental delay (HP:0001263): A delay in the achievement of motor or mental milestones in the domains of development of a child, including motor skills, speech and language, cognitive skills, and social and emotional skills. This term should only be used to describe children younger than five years of age. Evidence: TAS. Frequency: Very frequent (HP:0040281). (ORPHA:530983)
- Specific learning disability (HP:0001328): Impairment of certain skills such as reading or writing, coordination, self-control, or attention that interfere with the ability to learn. The impairment is not related to a global deficiency of intelligence. Evidence: TAS. Frequency: Very frequent (HP:0040281). (ORPHA:530983)
- Abnormal facial shape (HP:0001999): An abnormal morphology (form) of the face or its components. Evidence: TAS. Frequency: Very frequent (HP:0040281). (ORPHA:530983)
- Delayed ability to walk (HP:0031936): A failure to achieve the ability to walk at an appropriate developmental stage. Most children learn to walk in a series of stages, and learn to walk short distances independently between 12 and 15 months. Evidence: TAS. Frequency: Very frequent (HP:0040281). (ORPHA:530983)
- Strabismus (HP:0000486): A misalignment of the eyes so that the visual axes deviate from bifoveal fixation. The classification of strabismus may be based on a number of features including the relative position of the eyes, whether the deviation is latent or manifest, intermittent or constant, concomitant or otherwise and according to the age of onset and the relevance of any associated refractive error. Evidence: TAS. Frequency: Frequent (HP:0040282). (ORPHA:530983)
- Delayed speech and language development (HP:0000750): A degree of language development that is significantly below the norm for a child of a specified age. Evidence: TAS. Frequency: Frequent (HP:0040282). (ORPHA:530983)
- Hypotonia (HP:0001252): Hypotonia is an abnormally low muscle tone (the amount of tension or resistance to movement in a muscle). Even when relaxed, muscles have a continuous and passive partial contraction which provides some resistance to passive stretching. Hypotonia thus manifests as diminished resistance to passive stretching. Hypotonia is not the same as muscle weakness, although the two conditions can co-exist. Evidence: TAS. Frequency: Frequent (HP:0040282). (ORPHA:530983)
- Mild intellectual disability (HP:0001256): Mild intellectual disability (ID) is defined as a type of ID characterized by mildly sub-average adaptive functioning and intellectual functioning, with an intelligence quotient (IQ) the range of 50-69. Evidence: TAS. Frequency: Frequent (HP:0040282). (ORPHA:530983)
- Microcephaly (HP:0000252): Head circumference below 2 standard deviations below the mean for age and gender. Evidence: TAS. Frequency: Occasional (HP:0040283). (ORPHA:530983)
- Long face (HP:0000276): Facial height (length) is more than 2 standard deviations above the mean (objective); or, an apparent increase in the height (length) of the face (subjective). Evidence: TAS. Frequency: Occasional (HP:0040283). (ORPHA:530983)
- Epicanthus (HP:0000286): A fold of skin starting above the medial aspect of the upper eyelid and arching downward to cover, pass in front of and lateral to the medial canthus. Evidence: TAS. Frequency: Occasional (HP:0040283). (ORPHA:530983)
- Short chin (HP:0000331): Decreased vertical distance from the vermilion border of the lower lip to the inferior-most point of the chin. Evidence: TAS. Frequency: Occasional (HP:0040283). (ORPHA:530983)
- Micrognathia (HP:0000347): Developmental hypoplasia of the mandible. Evidence: TAS. Frequency: Occasional (HP:0040283). (ORPHA:530983)
- Broad nasal tip (HP:0000455): Increase in width of the nasal tip. Evidence: TAS. Frequency: Occasional (HP:0040283). (ORPHA:530983)
- Optic atrophy (HP:0000648): Atrophy of the optic nerve. Optic atrophy results from the death of the retinal ganglion cell axons that comprise the optic nerve and manifesting as a pale optic nerve on fundoscopy. Evidence: TAS. Frequency: Occasional (HP:0040283). (ORPHA:530983)
- Autistic behavior (HP:0000729): Persistent deficits in social interaction and communication and interaction as well as a markedly restricted repertoire of activity and interest as well as repetitive patterns of behavior. Evidence: TAS. Frequency: Occasional (HP:0040283). (ORPHA:530983)
- Motor stereotypy (HP:0000733): Use of the same abnormal action in response to certain triggers or at random. They may be used as a way to regulate one's internal state but must otherwise have no apparent functional purpose. Evidence: TAS. Frequency: Occasional (HP:0040283). (ORPHA:530983)
- Hyperactivity (HP:0000752): Hyperactivity is a condition characterized by constant and unusually high levels of activity, even in situations where it is deemed inappropriate. Evidence: TAS. Frequency: Occasional (HP:0040283). (ORPHA:530983)
- Seizure (HP:0001250): A seizure is an intermittent abnormality of nervous system physiology characterized by a transient occurrence of signs and/or symptoms due to abnormal excessive or synchronous neuronal activity in the brain. Evidence: TAS. Frequency: Occasional (HP:0040283). (ORPHA:530983)
- Ataxia (HP:0001251): Ataxia refers to impaired coordination of voluntary muscle movement. Cerebellar ataxia refers to ataxia due to dysfunction of the cerebellum. This causes a variety of elementary neurological deficits including asynergy (lack of coordination between muscles, limbs and joints), dysmetria (lack of ability to judge distances that can lead to under- or overshoot in grasping movements), and dysdiadochokinesia (inability to perform rapid movements requiring antagonizing muscle groups to be switched on and off repeatedly). Evidence: TAS. Frequency: Occasional (HP:0040283). (ORPHA:530983)
- Mild postnatal growth retardation (HP:0001530): A mild degree of slow or limited growth after birth, being between two and three standard deviations below age- and sex-related norms. Evidence: TAS. Frequency: Occasional (HP:0040283). (ORPHA:530983)
- Upper motor neuron dysfunction (HP:0002493): A functional anomaly of the upper motor neuron. The upper motor neurons are neurons of the primary motor cortex which project to the brainstem and spinal chord via the corticonuclear, corticobulbar and corticospinal (pyramidal) tracts. They are involved in control of voluntary movements. Dysfunction leads to weakness, impairment of fine motor movements, spasticity, hyperreflexia and abnormal pyramidal signs. Evidence: TAS. Frequency: Occasional (HP:0040283). (ORPHA:530983)
- Scoliosis (HP:0002650): The presence of an abnormal lateral curvature of the spine. Evidence: TAS. Frequency: Occasional (HP:0040283). (ORPHA:530983)
- Fused cervical vertebrae (HP:0002949): A congenital anomaly characterized by a joining (fusion) of two or more cervical vertebral bodies with one another. Evidence: TAS. Frequency: Occasional (HP:0040283). (ORPHA:530983)
- Feeding difficulties (HP:0011968): Impaired ability to eat related to problems gathering food and getting ready to suck, chew, or swallow it. Evidence: TAS. Frequency: Occasional (HP:0040283). (ORPHA:530983)
- Abnormal social behavior (HP:0012433): An abnormality of actions or reactions of a person exhibited during social interactions with other individuals. Evidence: TAS. Frequency: Occasional (HP:0040283). (ORPHA:530983)
- Thick vermilion border (HP:0012471): Increased width of the skin of vermilion border region of upper lip. Evidence: TAS. Frequency: Occasional (HP:0040283). (ORPHA:530983)
- Abnormal temper tantrums (HP:0025160): Temper tantrums are brief episodes of extreme, unpleasant, and sometimes aggressive behaviors in response to frustration or anger, which are a normal part of development in toddlers. Temper tantrums that occur more frequently in a given time and/or are more severe in symptomatology and/or longer in duration and/or inappropriate for the given age compared to a temper tantrum that naturally occurs as a part of the developmental process are classified as abnormal temper tantrums. Evidence: TAS. Frequency: Occasional (HP:0040283). (ORPHA:530983)
- Decreased head circumference (HP:0040195): An abnormally reduced head circumference in a growing child. Head circumference is measured with a nonelastic tape and comprises the distance from above the eyebrows and ears and around the back of the head. The measured HC is then plotted on an appropriate growth chart. Microcephaly is defined as a head circumference (HC) that is great than two standard deviations below the mean of age- and gender-matched population based samples. Severe microcephaly is defined with an HC that is three standard deviations below the mean. Evidence: TAS. Frequency: Occasional (HP:0040283). (ORPHA:530983)
- Amblyopia (HP:0000646): Reduced visual acuity that is uncorrectable by lenses in the absence of detectable anatomic defects in the eye or visual pathways. Evidence: TAS. Frequency: Very rare (HP:0040284). (ORPHA:530983)
- Hip dysplasia (HP:0001385): The presence of developmental dysplasia of the hip. Evidence: TAS. Frequency: Very rare (HP:0040284). (ORPHA:530983)
- Thoracic kyphosis (HP:0002942): Over curvature of the thoracic region, leading to a round back or if sever to a hump. Evidence: TAS. Frequency: Very rare (HP:0040284). (ORPHA:530983)
- Cerebral visual impairment (HP:0100704): A form of loss of vision caused by damage to the visual cortex rather than a defect in the eye. Evidence: TAS. Frequency: Very rare (HP:0040284). (ORPHA:530983)